Phenotypes associated with the disease vesicoureteral reflux 8 (OMIM:615963):
- Recurrent urinary tract infections (HP:0000010): Repeated infections of the urinary tract. Evidence: PCS. Frequency: 8/8. (PMID:23620400)
- Vesicoureteral reflux (HP:0000076): Abnormal (retrograde) movement of urine from the bladder into ureters or kidneys related to inadequacy of the valvular mechanism at the ureterovesicular junction or other causes. Evidence: PCS. Frequency: 5/9. (PMID:23620400)
- Joint hypermobility (HP:0001382): The capability that a joint (or a group of joints) has to move, passively and/or actively, beyond normal limits along physiological axes. Evidence: PCS. Frequency: 2/2. (PMID:23620400)
- Duplicated collecting system (HP:0000081): A duplication of the collecting system of the kidney, defined as a kidney with two (instead of, normally, one) pyelocaliceal systems. The pyelocaliceal system is comprised of the renal pelvis and calices. The duplicated renal collecting system can be associated with a single ureter or with double ureters. In the latter case, the two ureters empty separately into the bladder or fuse to form a single ureteral orifice. Evidence: PCS. Frequency: 5/9. (PMID:23620400)
- Autosomal dominant inheritance (HP:0000006): A mode of inheritance that is observed for traits related to a gene encoded on one of the autosomes (i.e., the human chromosomes 1-22) in which a trait manifests in heterozygotes. In the context of medical genetics, an autosomal dominant disorder is caused when a single copy of the mutant allele is present. Males and females are affected equally, and can both transmit the disorder with a risk of 50% for each child of inheriting the mutant allele. Evidence: PCS. (PMID:23620400)